Phenotypes associated with the disease type 1 diabetes mellitus 15 (OMIM:601666):
- Diabetes mellitus (HP:0000819): A group of abnormalities characterized by hyperglycemia and glucose intolerance. Evidence: IEA. (OMIM:601666)
- Type I diabetes mellitus (HP:0100651): A chronic condition in which the pancreas produces little or no insulin. Type I diabetes mellitus is manifested by the sudden onset of severe hyperglycemia with rapid progression to diabetic ketoacidosis unless treated with insulin. Evidence: TAS. (OMIM:601666)